- Abnormal cornea morphology (HP:0000481): Any abnormality of the cornea, which is the transparent tissue at the front of the eye that covers the iris, pupil, and anterior chamber. Evidence: TAS. Frequency: Very frequent (HP:0040281). (ORPHA:98964)
- Corneal scarring (HP:0000559). Evidence: TAS. Frequency: Very frequent (HP:0040281). (ORPHA:98964)
- Visual loss (HP:0000572): Loss of visual acuity (implying that vision was better at a certain time point in life). Otherwise the term reduced visual acuity should be used (or a subclass of that). Evidence: TAS. Frequency: Very frequent (HP:0040281). (ORPHA:98964)
- Lattice corneal dystrophy (HP:0001149): The presence of fine, branching linear opacities in Bowman's layer in the central area that may spread to the periphery in the clinical course. The deep corneal stroma may be involved but the process does not reach Descemet's membrane. Recurrent corneal erosion may occur. Histologic examination reveals amyloid deposits in the collagen fibers of the cornea. Evidence: TAS. Frequency: Very frequent (HP:0040281). (ORPHA:98964)
- Corneal opacity (HP:0007957): A reduction of corneal clarity. Evidence: TAS. Frequency: Very frequent (HP:0040281). (ORPHA:98964)
- Central opacification of the cornea (HP:0011493): Reduced transparency of the central portion of the corneal stroma. Evidence: TAS. Frequency: Very frequent (HP:0040281). (ORPHA:98964)
- Astigmatism (HP:0000483): A type of refraction error associated with abnormal curvatures on the anterior and/or posterior surface of the cornea. Evidence: TAS. Frequency: Frequent (HP:0040282). (ORPHA:98964)
- Recurrent corneal erosions (HP:0000495): The presence of recurrent corneal epithelial erosions. Although most corneal epithelial defects heal quickly, some may show recurrent ulcerations. Evidence: TAS. Frequency: Frequent (HP:0040282). (ORPHA:98964)
- Photophobia (HP:0000613): Excessive sensitivity to light with the sensation of discomfort or pain in the eyes due to exposure to bright light. Evidence: TAS. Frequency: Frequent (HP:0040282). (ORPHA:98964)
- Subepithelial corneal opacities (HP:0008039). Evidence: TAS. Frequency: Frequent (HP:0040282). (ORPHA:98964)
- Corneal stromal edema (HP:0012040): Abnormal accumulation of fluid and swelling of the stroma of cornea. Evidence: TAS. Frequency: Frequent (HP:0040282). (ORPHA:98964)
- Red eye (HP:0025337): A reddish appearance over the white part (sclera) of the eye ranging from a few enlarged blood vessels appearing as wiggly lines over the sclera to a bright red color completely covering to sclera. Evidence: TAS. Frequency: Frequent (HP:0040282). (ORPHA:98964)
- Ocular pain (HP:0200026): An unpleasant sensation characterized by physical discomfort (such as pricking, throbbing, or aching) localized to the eye. Evidence: TAS. Frequency: Frequent (HP:0040282). (ORPHA:98964)
- Slow decrease in visual acuity (HP:0007924). Evidence: TAS. Frequency: Occasional (HP:0040283). (ORPHA:98964)
- Central posterior corneal opacity (HP:0008511): Reduced transparency of the central posterior portion of the corneal stroma. Evidence: TAS. Frequency: Occasional (HP:0040283). (ORPHA:98964)
- High myopia (HP:0011003): A severe form of myopia with greater than -6.00 diopters. Evidence: TAS. Frequency: Occasional (HP:0040283). (ORPHA:98964)
- Decreased corneal sensation (HP:0012155): Reduced ability of the cornea to respond to stimulation. Evidence: TAS. Frequency: Occasional (HP:0040283). (ORPHA:98964)
These phenotypes are associated with the disease Lattice corneal dystrophy type I (ORPHA:98964).